Phenotypes associated with the disease familial ossifying fibroma (OMIM:137575):
- Tooth malposition (HP:0000692): Abnormal alignment, positioning, or spacing of the teeth, i.e., misaligned teeth. Evidence: TAS. (OMIM:137575)
- Multiple impacted teeth (HP:0001571): The presence of multiple impacted teeth. Evidence: TAS. (OMIM:137575)
- Cementoma (HP:0012328): An odontogenic tumor of the cementum of tooth. Evidence: TAS. (OMIM:137575)
- Autosomal dominant inheritance (HP:0000006): A mode of inheritance that is observed for traits related to a gene encoded on one of the autosomes (i.e., the human chromosomes 1-22) in which a trait manifests in heterozygotes. In the context of medical genetics, an autosomal dominant disorder is caused when a single copy of the mutant allele is present. Males and females are affected equally, and can both transmit the disorder with a risk of 50% for each child of inheriting the mutant allele. Evidence: TAS. (OMIM:137575)